Phenotypes associated with the disease Autosomal recessive Emery-Dreifuss muscular dystrophy (ORPHA:98855):
- Spinal rigidity (HP:0003306): Reduced ability to move the vertebral column with a resulting limitation of neck and trunk flexion. Evidence: TAS. Frequency: Frequent (HP:0040282). (ORPHA:98855)
- Back pain (HP:0003418): An unpleasant sensation characterized by physical discomfort (such as pricking, throbbing, or aching) localized to the back. Evidence: TAS. Frequency: Frequent (HP:0040282). (ORPHA:98855)
- EMG: myopathic abnormalities (HP:0003458): The presence of abnormal electromyographic patterns indicative of myopathy, such as small-short polyphasic motor unit potentials. Evidence: TAS. Frequency: Frequent (HP:0040282). (ORPHA:98855)
- Scapular winging (HP:0003691): Abnormal protrusion of the scapula away from the surface of the back. Evidence: TAS. Frequency: Frequent (HP:0040282). (ORPHA:98855)
- Rimmed vacuoles (HP:0003805): Presence of abnormal vacuoles (membrane-bound organelles) in the sarcolemma. On histological staining with hematoxylin and eosin, rimmed vacuoles are popcorn-like clear vacuoles with a densely blue rim. The vacuoles are often associated with cytoplasmic and occasionally intranuclear eosinophilic inclusions. Evidence: TAS. Frequency: Frequent (HP:0040282). (ORPHA:98855)
- Decreased cervical spine flexion due to contractures of posterior cervical muscles (HP:0004631). Evidence: TAS. Frequency: Frequent (HP:0040282). (ORPHA:98855)
- Supraventricular arrhythmia (HP:0005115): A type of arrhythmia that originates above the ventricles, whereby the electrical impulse propagates down the normal His Purkinje system similar to normal sinus rhythm. Evidence: TAS. Frequency: Frequent (HP:0040282). (ORPHA:98855)
- Ventricular escape rhythm (HP:0005155): A ventricular escape rhythm occurs whenever higher-lever pacemakers in AV junction or sinus node fail to control ventricular activation. Escape rate is usually 20-40 bpm, often associated with broad QRS complexes (at least 120 ms). Evidence: TAS. Frequency: Frequent (HP:0040282). (ORPHA:98855)
- Proximal upper limb amyotrophy (HP:0008948): Muscular atrophy affecting proximally located muscles of the arms. Evidence: TAS. Frequency: Frequent (HP:0040282). (ORPHA:98855)
- Proximal lower limb amyotrophy (HP:0008956): Muscular atrophy affecting proximally located muscles of the legs, i.e., of the thigh. Evidence: TAS. Frequency: Frequent (HP:0040282). (ORPHA:98855)
- Proximal lower limb muscle weakness (HP:0008994): A lack of strength of the proximal muscles of the legs. Evidence: TAS. Frequency: Frequent (HP:0040282). (ORPHA:98855)
- Proximal upper limb muscle weakness (HP:0008997): A lack of strength of the proximal muscles of the arms. Evidence: TAS. Frequency: Frequent (HP:0040282). (ORPHA:98855)
- Type 1 muscle fiber atrophy (HP:0011807): Atrophy (wasting) affecting primary type 1 muscle fibers. This feature in general can only be observed on muscle biopsy. Evidence: TAS. Frequency: Frequent (HP:0040282). (ORPHA:98855)
- Tip-toe gait (HP:0030051): An abnormal gait pattern characterized by the failure of the heel to contact the floor at the onset of stance during gait. Evidence: TAS. Frequency: Frequent (HP:0040282). (ORPHA:98855)
- Absent muscle fiber emerin (HP:0030117): Immunohistochemistry shows complete lack of emerin protein in the muscle biopsy. Evidence: TAS. Frequency: Frequent (HP:0040282). (ORPHA:98855)
- Hypotonia (HP:0001252): Hypotonia is an abnormally low muscle tone (the amount of tension or resistance to movement in a muscle). Even when relaxed, muscles have a continuous and passive partial contraction which provides some resistance to passive stretching. Hypotonia thus manifests as diminished resistance to passive stretching. Hypotonia is not the same as muscle weakness, although the two conditions can co-exist. Evidence: TAS. Frequency: Occasional (HP:0040283). (ORPHA:98855)
- Obesity (HP:0001513): Accumulation of substantial excess body fat. Evidence: TAS. Frequency: Occasional (HP:0040283). (ORPHA:98855)
- Scoliosis (HP:0002650): The presence of an abnormal lateral curvature of the spine. Evidence: TAS. Frequency: Occasional (HP:0040283). (ORPHA:98855)
- Kyphosis (HP:0002808): Exaggerated anterior convexity of the thoracic vertebral column. Evidence: TAS. Frequency: Occasional (HP:0040283). (ORPHA:98855)
- Hyperlordosis (HP:0003307): Abnormally increased curvature (anterior concavity) of the lumbar or cervical spine. Evidence: TAS. Frequency: Occasional (HP:0040283). (ORPHA:98855)
- Ichthyosis (HP:0008064): An abnormality of the skin characterized the presence of excessive amounts of dry surface scales on the skin resulting from an abnormality of keratinization. Evidence: TAS. Frequency: Occasional (HP:0040283). (ORPHA:98855)
- Lipodystrophy (HP:0009125): Degenerative changes of the fat tissue. Evidence: TAS. Frequency: Occasional (HP:0040283). (ORPHA:98855)
- Pectus excavatum (HP:0000767): A defect of the chest wall characterized by a depression of the sternum, giving the chest ("pectus") a caved-in ("excavatum") appearance. Evidence: TAS. Frequency: Very frequent (HP:0040281). (ORPHA:98855)
- Joint stiffness (HP:0001387): Joint stiffness is a perceived sensation of tightness in a joint or joints when attempting to move them after a period of inactivity. Joint stiffness typically subsides over time. Evidence: TAS. Frequency: Very frequent (HP:0040281). (ORPHA:98855)
- Myotonia (HP:0002486): An involuntary and painless delay in the relaxation of skeletal muscle following contraction or electrical stimulation. Evidence: TAS. Frequency: Very frequent (HP:0040281). (ORPHA:98855)
- Hyporeflexia of lower limbs (HP:0002600): Reduced intensity of muscle tendon reflexes in the lower limbs. Reflexes are elicited by stretching the tendon of a muscle, e.g., by tapping. Evidence: TAS. Frequency: Very frequent (HP:0040281). (ORPHA:98855)
- Myopathy (HP:0003198): A disorder of muscle unrelated to impairment of innervation or neuromuscular junction. Evidence: TAS. Frequency: Very frequent (HP:0040281). (ORPHA:98855)
- Elevated circulating creatine kinase activity (HP:0003236): The activity of creatine kinase in the blood circulation is above the upper limit of normal. Evidence: TAS. Frequency: Very frequent (HP:0040281). (ORPHA:98855)
- Limb-girdle muscular dystrophy (HP:0006785): Muscular dystrophy affecting the muscles of the limb girdle (the hips and shoulders). Evidence: TAS. Frequency: Very frequent (HP:0040281). (ORPHA:98855)
- Sprengel anomaly (HP:0000912): A congenital skeletal deformity characterized by the elevation of one scapula (thus, one scapula is located superior to the other). Evidence: TAS. Frequency: Frequent (HP:0040282). (ORPHA:98855)
- Gait disturbance (HP:0001288): The term gait disturbance can refer to any disruption of the ability to walk. Evidence: TAS. Frequency: Frequent (HP:0040282). (ORPHA:98855)
- Dilated cardiomyopathy (HP:0001644): Dilated cardiomyopathy (DCM) is defined by the presence of left ventricular dilatation and left ventricular systolic dysfunction in the absence of abnormal loading conditions (hypertension, valve disease) or coronary artery disease sufficient to cause global systolic impairment. Right ventricular dilation and dysfunction may be present but are not necessary for the diagnosis. Evidence: TAS. Frequency: Frequent (HP:0040282). (ORPHA:98855)
- Sudden cardiac death (HP:0001645): The heart suddenly and unexpectedly stops beating resulting in death within a short time period (generally within 1 h of symptom onset). Evidence: TAS. Frequency: Frequent (HP:0040282). (ORPHA:98855)
- Atrioventricular block (HP:0001678): Delayed or lack of conduction of atrial depolarizations through the atrioventricular node to the ventricles. Evidence: TAS. Frequency: Frequent (HP:0040282). (ORPHA:98855)
- Achilles tendon contracture (HP:0001771): A contracture of the Achilles tendon. Evidence: TAS. Frequency: Frequent (HP:0040282). (ORPHA:98855)
- Hypertriglyceridemia (HP:0002155): An abnormal increase in the level of triglycerides in the blood. Evidence: TAS. Frequency: Frequent (HP:0040282). (ORPHA:98855)
- Waddling gait (HP:0002515): Weakness of the hip girdle and upper thigh muscles, for instance in myopathies, leads to an instability of the pelvis on standing and walking. If the muscles extending the hip joint are affected, the posture in that joint becomes flexed and lumbar lordosis increases. The patients usually have difficulties standing up from a sitting position. Due to weakness in the gluteus medius muscle, the hip on the side of the swinging leg drops with each step (referred to as Trendelenburg sign). The gait appears waddling. The patients frequently attempt to counteract the dropping of the hip on the swinging side by bending the trunk towards the side which is in the stance phase (in the German language literature this is referred to as Duchenne sign). Similar gait patterns can be caused by orthopedic conditions when the origin and the insertion site of the gluteus medius muscle are closer to each other than normal, for instance due to a posttraumatic elevation of the trochanter or pseudarthrosis of the femoral neck. Evidence: TAS. Frequency: Frequent (HP:0040282). (ORPHA:98855)
- Elbow flexion contracture (HP:0002987): An elbow contracture that limits the ability of the elbow joint to be extended (straightened), meaning that the elbow is fixed in an flexed (bent) position. Evidence: TAS. Frequency: Frequent (HP:0040282). (ORPHA:98855)
- Elevated circulating LDL-C concentration (HP:0003141): The concentration of low-density lipoprotein cholesterol in the blood circulation is above the upper limit of normal. Evidence: TAS. Frequency: Frequent (HP:0040282). (ORPHA:98855)
Not associated with this disease:
- Intellectual disability (HP:0001249): The term intellectual disability or intellectual developmental disorder is used to describe significantly sub-average intellectual and adaptive functioning based on clinical assessment and as measured by individually administered, appropriately normed, standardized and validated tests of intellectual functioning and adaptive behavior, with onset during the developmental period from infancy through adolescence. Evidence: TAS. (ORPHA:98855)